- Patent urachus (HP:0010479): Persistence of the urachal canal resulting in a canal between the bladder and the umbilicus. Evidence: TAS. Frequency: Very frequent (HP:0040281). (ORPHA:431341)
- Abnormality of the umbilical cord (HP:0010881): An abnormality of the umbilical cord, which is the cord connecting the developing embryo or fetus to the placenta. Evidence: TAS. Frequency: Very frequent (HP:0040281). (ORPHA:431341)
- Recurrent urinary tract infections (HP:0000010): Repeated infections of the urinary tract. Evidence: TAS. Frequency: Frequent (HP:0040282). (ORPHA:431341)
- Abdominal pain (HP:0002027): An unpleasant sensation characterized by physical discomfort (such as pricking, throbbing, or aching) and perceived to originate in the abdomen. Evidence: TAS. Frequency: Frequent (HP:0040282). (ORPHA:431341)
- Urachal cyst (HP:0012618): A cyst located along the allantois canal. Evidence: TAS. Frequency: Frequent (HP:0040282). (ORPHA:431341)
- Pelvic pain (HP:0034267): Pain perceived in the area of the pelvis, the lower part of the abdomen located between the hip bones. Evidence: TAS. Frequency: Frequent (HP:0040282). (ORPHA:431341)
- Cystocele (HP:0100645): Anterior vaginal wall prolapse with bulging of the bladder into the vagina. Evidence: TAS. Frequency: Frequent (HP:0040282). (ORPHA:431341)
- Recurrent gram-negative bacterial infections (HP:0005420): Increased susceptibility to infection by gram-negative bacteria, as manifested by a medical history of repeated or frequent infections by these agents. Evidence: TAS. Frequency: Occasional (HP:0040283). (ORPHA:431341)
- Congenital posterior urethral valve (HP:0010957): A developmental defect resulting in an obstructing membrane in the posterior male urethra. Evidence: TAS. Frequency: Occasional (HP:0040283). (ORPHA:431341)
- Neonatal omphalitis (HP:0032435): An infection of the umbilicus and/or surrounding tissues occurring in the neonatal period. Evidence: TAS. Frequency: Occasional (HP:0040283). (ORPHA:431341)
These phenotypes are associated with the disease Patent urachus (ORPHA:431341).